- Oculomotor apraxia (HP:0000657): Ocular motor apraxia is a deficiency in voluntary, horizontal, lateral, fast eye movements (saccades) with retention of slow pursuit movements. The inability to follow objects visually is often compensated by head movements. There may be decreased smooth pursuit, and cancelation of the vestibulo-ocular reflex. Evidence: TAS. Frequency: Very frequent (HP:0040281). (ORPHA:54247)
- Anxiety (HP:0000739): Intense feelings of nervousness, tension, or panic often arise in response to interpersonal stresses. There is worry about the negative effects of past unpleasant experiences and future negative possibilities. Individuals may feel fearful, apprehensive, or threatened by uncertainty, and they may also have fears of falling apart or losing control. Evidence: TAS. Frequency: Very frequent (HP:0040281). (ORPHA:54247)
- Ataxia (HP:0001251): Ataxia refers to impaired coordination of voluntary muscle movement. Cerebellar ataxia refers to ataxia due to dysfunction of the cerebellum. This causes a variety of elementary neurological deficits including asynergy (lack of coordination between muscles, limbs and joints), dysmetria (lack of ability to judge distances that can lead to under- or overshoot in grasping movements), and dysdiadochokinesia (inability to perform rapid movements requiring antagonizing muscle groups to be switched on and off repeatedly). Evidence: TAS. Frequency: Very frequent (HP:0040281). (ORPHA:54247)
- Confusion (HP:0001289): Lack of clarity and coherence of thought, perception, understanding, or action. Evidence: TAS. Frequency: Very frequent (HP:0040281). (ORPHA:54247)
- Dyscalculia (HP:0002442): A specific learning disability involving mathematics and arithmetic. Evidence: TAS. Frequency: Very frequent (HP:0040281). (ORPHA:54247)
- Alexia (HP:0010523): An acquired type of sensory aphasia where damage to the brain leads to the loss of the ability to read. Evidence: TAS. Frequency: Very frequent (HP:0040281). (ORPHA:54247)
- Disturbed sensory perception (HP:0010524): Alteration or impairment in the processing or interpretation of sensory information can lead to abnormal perceptions or experiences. Evidence: TAS. Frequency: Very frequent (HP:0040281). (ORPHA:54247)
- Finger agnosia (HP:0010525): The examiner identified the inability to name, move, or touch specific fingers. Evidence: TAS. Frequency: Very frequent (HP:0040281). (ORPHA:54247)
- Dysgraphia (HP:0010526): A writing disability in the absence of motor or sensory deficits of the upper extremities, resulting in an impairment in the ability to write regardless of the ability to read and not due to intellectual impairment. Evidence: TAS. Frequency: Very frequent (HP:0040281). (ORPHA:54247)
- Cerebral visual impairment (HP:0100704): A form of loss of vision caused by damage to the visual cortex rather than a defect in the eye. Evidence: TAS. Frequency: Very frequent (HP:0040281). (ORPHA:54247)
- Abnormality of vision (HP:0000504): Abnormality of eyesight (visual perception). Evidence: TAS. Frequency: Frequent (HP:0040282). (ORPHA:54247)
- Color vision defect (HP:0000551): An anomaly in the ability to discriminate between or recognize colors. Evidence: TAS. Frequency: Frequent (HP:0040282). (ORPHA:54247)
- Photophobia (HP:0000613): Excessive sensitivity to light with the sensation of discomfort or pain in the eyes due to exposure to bright light. Evidence: TAS. Frequency: Frequent (HP:0040282). (ORPHA:54247)
- Dyslexia (HP:0010522): A learning disorder characterized primarily by difficulties in learning to read and spell. Dyslectic children also exhibit a tendency to read words from right to left and to confuse letters such as b and d whose orientation is important for their identification. Children with dyslexia appear to be impaired in phonemic skills (the ability to associate visual symbols with the sounds they represent). Evidence: TAS. Frequency: Frequent (HP:0040282). (ORPHA:54247)
- Limb apraxia (HP:0030217): Difficulty in performing the correct execution of limbs movements in absence of motor impairment. Evidence: TAS. Frequency: Frequent (HP:0040282). (ORPHA:54247)
- Memory impairment (HP:0002354): An impairment of memory as manifested by a reduced ability to remember things such as dates and names, and increased forgetfulness. Evidence: TAS. Frequency: Occasional (HP:0040283). (ORPHA:54247)
- Visual hallucination (HP:0002367): Visual perception in the absence of a visual stimulus. Evidence: TAS. Frequency: Occasional (HP:0040283). (ORPHA:54247)
- Language impairment (HP:0002463): Language impairment is a deficit in comprehension or production of language that includes reduced vocabulary, limited sentence structure, or impairments in written or spoken communication. Language abilities are substantially and quantifiably below age expectations. Evidence: TAS. Frequency: Occasional (HP:0040283). (ORPHA:54247)
- Abnormal rapid eye movement sleep (HP:0002494): Abnormality of REM Sleep are phases of REM sleep are characterized by desynchronized EEG patterns, increases in heart rate and blood pressure, sympathetic activation, and a profound loss of muscle tone except for the eye and middle-ear muscles. There are also phases of rapid eye movements. Evidence: TAS. Frequency: Occasional (HP:0040283). (ORPHA:54247)
- Speech apraxia (HP:0011098): A type of apraxia that is characterized by difficulty or inability to execute speech movements because of problems with coordination and motor problems, leading to incorrect articulation. An increase of errors with increasing word and phrase length may occur. Evidence: TAS. Frequency: Occasional (HP:0040283). (ORPHA:54247)
- Inertia (HP:0030216): Reduction of goal-directed behaviors linked to the impairment in frontal executive functions (planning of an action for example). Evidence: TAS. Frequency: Occasional (HP:0040283). (ORPHA:54247)
These phenotypes are associated with the disease Posterior cortical atrophy (ORPHA:54247).